Phenotypes associated with the disease Congenital analbuminemia (ORPHA:86816):
- Edema (HP:0000969): An abnormal accumulation of fluid beneath the skin, or in one or more cavities of the body. Evidence: TAS. Frequency: Very frequent (HP:0040281). (ORPHA:86816)
- Hypoalbuminemia (HP:0003073): The concentration of albumin in the blood circulation is below the lower limit of normal. Evidence: TAS. Frequency: Very frequent (HP:0040281). (ORPHA:86816)
- Small for gestational age (HP:0001518): Smaller than normal size according to sex and gestational age related norms, defined as a weight below the 10th percentile for the gestational age. Evidence: TAS. Frequency: Frequent (HP:0040282). (ORPHA:86816)
- Premature birth (HP:0001622): The birth of a baby of less than 37 weeks of gestational age. Evidence: TAS. Frequency: Frequent (HP:0040282). (ORPHA:86816)
- Hypoproteinemia (HP:0003075): A decreased concentration of protein in the blood. Evidence: TAS. Frequency: Frequent (HP:0040282). (ORPHA:86816)
- Hyperlipidemia (HP:0003077): An elevated lipid concentration in the blood. Evidence: TAS. Frequency: Frequent (HP:0040282). (ORPHA:86816)
- Hypercholesterolemia (HP:0003124): An increased concentration of cholesterol in the blood. Evidence: TAS. Frequency: Frequent (HP:0040282). (ORPHA:86816)
- Elevated circulating alpha-globulin concentration (HP:0005413): The concentration of alpha-globulin in the blood circulation is above the upper limit of normal. Evidence: TAS. Frequency: Frequent (HP:0040282). (ORPHA:86816)
- Lipodystrophy (HP:0009125): Degenerative changes of the fat tissue. Evidence: TAS. Frequency: Frequent (HP:0040282). (ORPHA:86816)
- Increased circulating immunoglobulin concentration (HP:0010702): An increased level of gamma globulin (immunoglobulin) in the blood. Evidence: TAS. Frequency: Frequent (HP:0040282). (ORPHA:86816)
- Pedal edema (HP:0010741): An abnormal accumulation of excess fluid in the lower extremity resulting in swelling of the feet and extending upward to the lower leg. Evidence: TAS. Frequency: Frequent (HP:0040282). (ORPHA:86816)
- Fatigue (HP:0012378): A subjective feeling of tiredness characterized by a lack of energy and motivation. Evidence: TAS. Frequency: Frequent (HP:0040282). (ORPHA:86816)
- Facial edema (HP:0000282). Evidence: TAS. Frequency: Occasional (HP:0040283). (ORPHA:86816)
- Obesity (HP:0001513): Accumulation of substantial excess body fat. Evidence: TAS. Frequency: Occasional (HP:0040283). (ORPHA:86816)
- Oligohydramnios (HP:0001562): Diminished amniotic fluid volume in pregnancy. Evidence: TAS. Frequency: Occasional (HP:0040283). (ORPHA:86816)
- Recurrent lower respiratory tract infections (HP:0002783): An increased susceptibility to lower respiratory tract infections as manifested by a history of recurrent lower respiratory tract infections. Evidence: TAS. Frequency: Occasional (HP:0040283). (ORPHA:86816)
- Miscarriage (HP:0005268): A pregnancy that ends at a stage in which the fetus is incapable of surviving on its own, defined as the spontaneous loss of a fetus before the 22th week of pregnancy. Evidence: TAS. Frequency: Occasional (HP:0040283). (ORPHA:86816)
- Mild global developmental delay (HP:0011342): A mild delay in the achievement of motor or mental milestones in the domains of development of a child. Evidence: TAS. Frequency: Occasional (HP:0040283). (ORPHA:86816)
- Low pulse pressure (HP:0030851): Reduced amplitude of the pulse pressure (systolic blood pressure minus diastolic blood pressure). Evidence: TAS. Frequency: Occasional (HP:0040283). (ORPHA:86816)